Phenotypes associated with the disease Trigeminal neuralgia (ORPHA:221091):
- Trigeminal neuralgia (HP:0100661): A neuropathic disorder characterized by episodes of intense pain in the face, originating from the trigeminal nerve. One, two, or all three branches of the nerve may be affected. Evidence: TAS. Frequency: Obligate (HP:0040280). (ORPHA:221091)
- Depression (HP:0000716): Frequently experiencing feelings of being down, miserable, and/or hopeless; struggling to recover from these moods; having a pessimistic outlook on the future; feeling a pervasive sense of shame; having a low self-worth; experiencing thoughts of suicide and engaging in suicidal behavior. Evidence: TAS. Frequency: Very frequent (HP:0040281). (ORPHA:221091)
- Cluster headache (HP:0012199): A type of headache characterized by repeated attacks of unilateral pain lasting 15 to 180 minutes and associated with local autonomic signs. Evidence: TAS. Frequency: Very frequent (HP:0040281). (ORPHA:221091)
- Allodynia (HP:0012533): Pain due to a stimulus that does not normally provoke pain. Evidence: TAS. Frequency: Very frequent (HP:0040281). (ORPHA:221091)
- Tongue muscle weakness (HP:0000183): Reduced strength of the tongue musculature, resulting in difficulties moving the tongue and possible accompanied by dysarthria or dysphagia. Evidence: TAS. Frequency: Frequent (HP:0040282). (ORPHA:221091)
- Episodic paroxysmal anxiety (HP:0000740): Recurrent attacks of severe anxiety, which occur without restriction to any particular situation or set of circumstances, are therefore unpredictable. Evidence: TAS. Frequency: Frequent (HP:0040282). (ORPHA:221091)
- Poor speech (HP:0002465). Evidence: TAS. Frequency: Frequent (HP:0040282). (ORPHA:221091)
- Paresthesia (HP:0003401): Abnormal sensations such as tingling, pricking, or numbness of the skin with no apparent physical cause. Evidence: TAS. Frequency: Frequent (HP:0040282). (ORPHA:221091)
- Somatic sensory dysfunction (HP:0003474): An abnormality of the primary sensation that is mediated by peripheral nerves (pain, temperature, touch, vibration, joint position). The word hypoesthesia (or hypesthesia) refers to a reduction in cutaneous sensation to a specific type of testing. Evidence: TAS. Frequency: Frequent (HP:0040282). (ORPHA:221091)
- Vascular tortuosity (HP:0004948): Abnormal twisting of arteries or veins. Evidence: TAS. Frequency: Frequent (HP:0040282). (ORPHA:221091)
- Feeding difficulties (HP:0011968): Impaired ability to eat related to problems gathering food and getting ready to suck, chew, or swallow it. Evidence: TAS. Frequency: Frequent (HP:0040282). (ORPHA:221091)
- Mandibular pain (HP:0200025): An unpleasant sensation characterized by physical discomfort (such as pricking, throbbing, or aching) localized to the mandible. Evidence: TAS. Frequency: Frequent (HP:0040282). (ORPHA:221091)
- Cranial nerve compression (HP:0001293). Evidence: TAS. Frequency: Occasional (HP:0040283). (ORPHA:221091)
- Neoplasm (HP:0002664): An organ or organ-system abnormality that consists of uncontrolled autonomous cell-proliferation which can occur in any part of the body as a benign or malignant neoplasm (tumor). Evidence: TAS. Frequency: Occasional (HP:0040283). (ORPHA:221091)
- CNS demyelination (HP:0007305): A loss of myelin from nerve fibers in the central nervous system. Evidence: TAS. Frequency: Occasional (HP:0040283). (ORPHA:221091)
- Peripheral demyelination (HP:0011096): A loss of myelin from the internode regions along myelinated nerve fibers of the peripheral nervous system. Evidence: TAS. Frequency: Occasional (HP:0040283). (ORPHA:221091)
- Ocular pain (HP:0200026): An unpleasant sensation characterized by physical discomfort (such as pricking, throbbing, or aching) localized to the eye. Evidence: TAS. Frequency: Occasional (HP:0040283). (ORPHA:221091)